Phenotypes associated with the disease Machado-Joseph disease type 1 (ORPHA:276238):
- Progressive external ophthalmoplegia (HP:0000590): Initial bilateral ptosis followed by limitation of eye movements in all directions and slowing of saccades. Evidence: TAS. Frequency: Very frequent (HP:0040281). (ORPHA:276238)
- Dystonia (HP:0001332): An abnormally increased muscular tone that causes fixed abnormal postures. There is a slow, intermittent twisting motion that leads to exaggerated turning and posture of the extremities and trunk. Evidence: TAS. Frequency: Very frequent (HP:0040281). (ORPHA:276238)
- Abnormality of extrapyramidal motor function (HP:0002071): A neurological condition related to lesions of the basal ganglia leading to typical abnormalities including akinesia (inability to initiate changes in activity and perform volitional movements rapidly and easily), muscular rigidity (continuous contraction of muscles with constant resistance to passive movement), chorea (widespread arrhythmic movements of a forcible, rapid, jerky, and restless nature), athetosis (inability to sustain the muscles of the fingers, toes, or other group of muscles in a fixed position), and akathisia (inability to remain motionless). Evidence: TAS. Frequency: Very frequent (HP:0040281). (ORPHA:276238)
- Progressive cerebellar ataxia (HP:0002073). Evidence: TAS. Frequency: Very frequent (HP:0040281). (ORPHA:276238)
- Upper motor neuron dysfunction (HP:0002493): A functional anomaly of the upper motor neuron. The upper motor neurons are neurons of the primary motor cortex which project to the brainstem and spinal chord via the corticonuclear, corticobulbar and corticospinal (pyramidal) tracts. They are involved in control of voluntary movements. Dysfunction leads to weakness, impairment of fine motor movements, spasticity, hyperreflexia and abnormal pyramidal signs. Evidence: TAS. Frequency: Very frequent (HP:0040281). (ORPHA:276238)
- Abnormal pyramidal sign (HP:0007256): Functional neurological abnormalities related to dysfunction of the pyramidal tract. Evidence: TAS. Frequency: Very frequent (HP:0040281). (ORPHA:276238)
- Peripheral neuropathy (HP:0009830): Peripheral neuropathy is a general term for any disorder of the peripheral nervous system. The main clinical features used to classify peripheral neuropathy are distribution, type (mainly demyelinating versus mainly axonal), duration, and course. Evidence: TAS. Frequency: Very frequent (HP:0040281). (ORPHA:276238)
- Proptosis (HP:0000520): An eye that is protruding anterior to the plane of the face to a greater extent than is typical. Evidence: TAS. Frequency: Frequent (HP:0040282). (ORPHA:276238)
- Supranuclear ophthalmoplegia (HP:0000623): A vertical gaze palsy with inability to direct the gaze of the eyes downwards. Evidence: TAS. Frequency: Frequent (HP:0040282). (ORPHA:276238)
- Gaze-evoked nystagmus (HP:0000640): Nystagmus made apparent by looking to the right or to the left. Evidence: TAS. Frequency: Frequent (HP:0040282). (ORPHA:276238)
- Diplopia (HP:0000651): Diplopia is a condition in which a single object is perceived as two images, it is also known as double vision. Evidence: TAS. Frequency: Frequent (HP:0040282). (ORPHA:276238)
- Delayed speech and language development (HP:0000750): A degree of language development that is significantly below the norm for a child of a specified age. Evidence: TAS. Frequency: Frequent (HP:0040282). (ORPHA:276238)
- Spasticity (HP:0001257): A motor disorder characterized by a velocity-dependent increase in tonic stretch reflexes with increased muscle tone, exaggerated (hyperexcitable) tendon reflexes. Evidence: TAS. Frequency: Frequent (HP:0040282). (ORPHA:276238)
- Dysarthria (HP:0001260): Dysarthric speech is a general description referring to a neurological speech disorder characterized by poor articulation. Depending on the involved neurological structures, dysarthria may be further classified as spastic, flaccid, ataxic, hyperkinetic and hypokinetic, or mixed. Evidence: TAS. Frequency: Frequent (HP:0040282). (ORPHA:276238)
- Cerebellar atrophy (HP:0001272): Cerebellar atrophy is defined as a cerebellum with initially normal structures, in a posterior fossa with normal size, which displays enlarged fissures (interfolial spaces) in comparison to the foliae secondary to loss of tissue. Cerebellar atrophy implies irreversible loss of tissue and result from an ongoing progressive disease until a final stage is reached or a single injury, e.g. an intoxication or infectious event. Evidence: TAS. Frequency: Frequent (HP:0040282). (ORPHA:276238)
- Hyperreflexia (HP:0001347): Hyperreflexia is the presence of hyperactive stretch reflexes of the muscles. Evidence: TAS. Frequency: Frequent (HP:0040282). (ORPHA:276238)
- Dilated fourth ventricle (HP:0002198): An abnormal dilatation of the fourth cerebral ventricle. Evidence: TAS. Frequency: Frequent (HP:0040282). (ORPHA:276238)
- Clumsiness (HP:0002312): Lack of physical coordination resulting in an abnormal tendency to drop items or bump into objects. Evidence: TAS. Frequency: Frequent (HP:0040282). (ORPHA:276238)
- Spinocerebellar tract degeneration (HP:0002503). Evidence: TAS. Frequency: Frequent (HP:0040282). (ORPHA:276238)
- Skeletal muscle atrophy (HP:0003202): The presence of skeletal muscular atrophy (which is also known as amyotrophy). Evidence: TAS. Frequency: Frequent (HP:0040282). (ORPHA:276238)
- Babinski sign (HP:0003487): Upturning of the big toe (and sometimes fanning of the other toes) in response to stimulation of the sole of the foot. If the Babinski sign is present it can indicate damage to the corticospinal tract. Evidence: TAS. Frequency: Frequent (HP:0040282). (ORPHA:276238)
- Facial-lingual fasciculations (HP:0007089): Fasciculations affecting the tongue muscle and the musculature of the face. Evidence: TAS. Frequency: Frequent (HP:0040282). (ORPHA:276238)
- Progressive gait ataxia (HP:0007240): A type of gait ataxia displaying progression of clinical severity. Evidence: TAS. Frequency: Frequent (HP:0040282). (ORPHA:276238)
- Substantia nigra gliosis (HP:0011960): Focal proliferation of glial cells in the substantia nigra. Evidence: TAS. Frequency: Frequent (HP:0040282). (ORPHA:276238)
- Degeneration of the striatum (HP:0040140). Evidence: TAS. Frequency: Frequent (HP:0040282). (ORPHA:276238)
- Neurogenic bladder (HP:0000011): A type of bladder dysfunction caused by neurologic damage. Neurogenic bladder can be flaccid or spastic. Common manifestatios of neurogenic bladder are overflow incontinence, frequency, urgency, urge incontinence, and retention. Evidence: TAS. Frequency: Occasional (HP:0040283). (ORPHA:276238)
- Vocal cord paralysis (HP:0001605): A loss of the ability to move the vocal folds. Evidence: TAS. Frequency: Occasional (HP:0040283). (ORPHA:276238)
- Abnormal vestibular function (HP:0001751): An abnormality of the functioning of the vestibular apparatus. Evidence: TAS. Frequency: Occasional (HP:0040283). (ORPHA:276238)
- Dysphagia (HP:0002015): Difficulty in swallowing. Evidence: TAS. Frequency: Occasional (HP:0040283). (ORPHA:276238)
- Memory impairment (HP:0002354): An impairment of memory as manifested by a reduced ability to remember things such as dates and names, and increased forgetfulness. Evidence: TAS. Frequency: Occasional (HP:0040283). (ORPHA:276238)
- Sleep disturbance (HP:0002360): An abnormal pattern in the quality, quantity, or characteristics of sleep. Evidence: TAS. Frequency: Occasional (HP:0040283). (ORPHA:276238)
- Muscle spasm (HP:0003394): Sudden and involuntary contractions of one or more muscles. Evidence: TAS. Frequency: Occasional (HP:0040283). (ORPHA:276238)
- Abnormality of temperature regulation (HP:0004370): An abnormality of temperature homeostasis. Evidence: TAS. Frequency: Occasional (HP:0040283). (ORPHA:276238)
- Distal lower limb amyotrophy (HP:0008944): Muscular atrophy of distal leg muscles. Evidence: TAS. Frequency: Occasional (HP:0040283). (ORPHA:276238)